Phenotypes associated with the disease developmental delay with variable cardiac and renal congenital anomalies and dysmorphic facies (OMIM:621384):
- Hyperopic astigmatism (HP:0000484): A form of astigmatism in which one meridian is hyperopic while the one at a right angle to it has no refractive error. Evidence: PCS. Frequency: 1/5. (PMID:35304602)
- Decreased body weight (HP:0004325): Abnormally low body weight. Evidence: PCS. Frequency: 2/4. (PMID:35304602)
- Neoplasm (HP:0002664): An organ or organ-system abnormality that consists of uncontrolled autonomous cell-proliferation which can occur in any part of the body as a benign or malignant neoplasm (tumor). Evidence: PCS. Frequency: 1/1. (PMID:35304602)
- Anal atresia (HP:0002023): Congenital absence of the anus, i.e., the opening at the bottom end of the intestinal tract. Evidence: PCS. Frequency: 1/1. (PMID:40491293)
- Strabismus (HP:0000486): A misalignment of the eyes so that the visual axes deviate from bifoveal fixation. The classification of strabismus may be based on a number of features including the relative position of the eyes, whether the deviation is latent or manifest, intermittent or constant, concomitant or otherwise and according to the age of onset and the relevance of any associated refractive error. Evidence: PCS. Frequency: 2/4. (PMID:35304602)
- Short stature (HP:0004322): A height below that which is expected according to age and gender norms. Although there is no universally accepted definition of short stature, many refer to "short stature" as height more than 2 standard deviations below the mean for age and gender (or below the 3rd percentile for age and gender dependent norms). Evidence: PCS. Frequency: 3/4. (PMID:35304602;PMID:40491293)
- Trigonocephaly (HP:0000243): Wedge-shaped, or triangular head, with the apex of the triangle at the midline of the forehead and the base of the triangle at the occiput. Evidence: PCS. Frequency: 1/1. (PMID:29620724)
- Moderate to late preterm birth (HP:0025664): Birth at 32 to 36 completed weeks of gestation. Evidence: PCS. Frequency: 1/1. (PMID:29620724)
- Renal insufficiency (HP:0000083): A reduction in the level of performance of the kidneys in areas of function comprising the concentration of urine, removal of wastes, the maintenance of electrolyte balance, homeostasis of blood pressure, and calcium metabolism. Evidence: PCS. Frequency: 1/1. (PMID:35304602)
- Ectopic kidney (HP:0000086): A developmental defect in which a kidney is located in an abnormal anatomic position. Evidence: PCS. Frequency: 1/1. (PMID:35304602)
- Gastroesophageal reflux (HP:0002020): A condition in which the stomach contents leak backwards from the stomach into the esophagus through the lower esophageal sphincter. Evidence: PCS. Frequency: 1/1. (PMID:29620724)
- Gait imbalance (HP:0002141). Evidence: PCS. Frequency: 1/1. (PMID:35304602)
- Duplicated collecting system (HP:0000081): A duplication of the collecting system of the kidney, defined as a kidney with two (instead of, normally, one) pyelocaliceal systems. The pyelocaliceal system is comprised of the renal pelvis and calices. The duplicated renal collecting system can be associated with a single ureter or with double ureters. In the latter case, the two ureters empty separately into the bladder or fuse to form a single ureteral orifice. Evidence: PCS. Frequency: 1/1. (PMID:29620724)
- Anal fistula (HP:0010447): An abnormal connection between the epithelialised surface of the anal canal and the perianal skin. Evidence: PCS. Frequency: 1/1. (PMID:35304602)
- Overlapping toe (HP:0001845): Describes a foot digit resting on the dorsal surface of an adjacent digit when the foot is at rest. Initially clawing may be dynamic and only noticeable on walking. Over time the plantar plate tears, subluxation occurs at the metatarsophalangeal joint (MTPJ), and the deformity becomes permanent. Evidence: PCS. Frequency: 1/1. (PMID:40491293)
- High hypermetropia (HP:0008499): A severe form of hypermetropia with over +5.00 diopters. Evidence: PCS. Frequency: 1/1. (PMID:35304602)
- Posteriorly rotated ears (HP:0000358): A type of abnormal location of the ears in which the position of the ears is characterized by posterior rotation (the superior part of the ears is rotated towards the back of the head, and the inferior part of the ears towards the front). Evidence: PCS. Frequency: 1/1. (PMID:29620724)
- Microcephaly (HP:0000252): Head circumference below 2 standard deviations below the mean for age and gender. Evidence: PCS. Frequency: 1/2. (PMID:35304602;PMID:40491293)
- Recurrent urinary tract infections (HP:0000010): Repeated infections of the urinary tract. Evidence: PCS. Frequency: 1/1. (PMID:35304602)
- Downslanted palpebral fissures (HP:0000494): The palpebral fissure inclination is more than two standard deviations below the mean. Evidence: PCS. Frequency: 2/5. (PMID:35304602)
- Deeply set eye (HP:0000490): An eye that is more deeply recessed into the plane of the face than is typical. Evidence: PCS. Frequency: 1/5. (PMID:35304602)
- Sensorineural hearing impairment (HP:0000407): A type of hearing impairment in one or both ears related to an abnormal functionality of the cochlear nerve. Evidence: PCS. Frequency: 5/5. (PMID:35304602)
- Pectus excavatum (HP:0000767): A defect of the chest wall characterized by a depression of the sternum, giving the chest ("pectus") a caved-in ("excavatum") appearance. Evidence: PCS. Frequency: 1/1. (PMID:40491293)
- Recurrent otitis media (HP:0000403): Increased susceptibility to otitis media, as manifested by recurrent episodes of otitis media. Evidence: PCS. Frequency: 1/1. (PMID:35304602)
- Autosomal recessive inheritance (HP:0000007): A mode of inheritance that is observed for traits related to a gene encoded on one of the autosomes (i.e., the human chromosomes 1-22) in which a trait manifests in individuals with two pathogenic alleles, either homozygotes (two copies of the same mutant allele) or compound heterozygotes (whereby each copy of a gene has a distinct mutant allele). Evidence: PCS. (PMID:29620724)
- Clinodactyly of the 5th finger (HP:0004209): Clinodactyly refers to a bending or curvature of the fifth finger in the radial direction (i.e., towards the 4th finger). Evidence: PCS. Frequency: 2/2. (PMID:35304602)
- Autoimmune thrombocytopenia (HP:0001973): The presence of thrombocytopenia in combination with detection of antiplatelet antibodies. Evidence: PCS. Frequency: 1/1. (PMID:35304602)
- Low-set ears (HP:0000369): Upper insertion of the ear to the scalp below an imaginary horizontal line drawn between the inner canthi of the eye and extending posteriorly to the ear. Evidence: PCS. Frequency: 4/6. (PMID:35304602;PMID:29620724)
- Pancreatitis (HP:0001733): The presence of inflammation in the pancreas. Evidence: PCS. Frequency: 1/1. (PMID:35304602)
- Brachycephaly (HP:0000248): An abnormality of skull shape characterized by a decreased anterior-posterior diameter. That is, a cephalic index greater than 81%. Alternatively, an apparently shortened anteroposterior dimension (length) of the head compared to width. Evidence: PCS. Frequency: 2/5. (PMID:35304602)
- Upslanted palpebral fissure (HP:0000582): The palpebral fissure inclination is more than two standard deviations above the mean for age (objective); or, the inclination of the palpebral fissure is greater than typical for age. Evidence: PCS. Frequency: 1/1. (PMID:29620724)
- Congenital onset (HP:0003577): A phenotypic abnormality that is present at birth. Evidence: PCS. Frequency: 5/5. (PMID:35304602;PMID:40491293;PMID:29620724)
- Long philtrum (HP:0000343): Distance between nasal base and midline upper lip vermilion border more than 2 SD above the mean. Alternatively, an apparently increased distance between nasal base and midline upper lip vermilion border. Evidence: PCS. Frequency: 1/1. (PMID:29620724)
- Anteverted nares (HP:0000463): Anteriorly-facing nostrils viewed with the head in the Frankfurt horizontal and the eyes of the observer level with the eyes of the subject. This gives the appearance of an upturned nose (upturned nasal tip). Evidence: PCS. Frequency: 1/1. (PMID:29620724)
- Sparse hair (HP:0008070): Reduced density of hairs. Evidence: PCS. Frequency: 1/5. (PMID:35304602)
- Broad forehead (HP:0000337): Width of the forehead or distance between the frontotemporales is more than two standard deviations above the mean (objective); or apparently increased distance between the two sides of the forehead. Evidence: PCS. Frequency: 2/6. (PMID:35304602;PMID:40491293)
- Thin upper lip vermilion (HP:0000219): Height of the vermilion of the upper lip in the midline more than 2 SD below the mean. Alternatively, an apparently reduced height of the vermilion of the upper lip in the frontal view (subjective). Evidence: PCS. Frequency: 4/6. (PMID:35304602;PMID:40491293)
- High palate (HP:0000218): Height of the palate more than 2 SD above the mean (objective) or palatal height at the level of the first permanent molar more than twice the height of the teeth (subjective). Evidence: PCS. Frequency: 2/6. (PMID:35304602;PMID:29620724)
- Clinodactyly (HP:0030084): An angulation of a digit at an interphalangeal joint in the plane of the palm (finger) or sole (toe). Evidence: PCS. Frequency: 1/1. (PMID:35304602)
- Delayed speech and language development (HP:0000750): A degree of language development that is significantly below the norm for a child of a specified age. Evidence: PCS. Frequency: 2/2. (PMID:35304602;PMID:40491293)
- Scoliosis (HP:0002650): The presence of an abnormal lateral curvature of the spine. Evidence: PCS. Frequency: 1/1. (PMID:29620724)
- Long nose (HP:0003189): Distance from nasion to subnasale more than two standard deviations above the mean, or alternatively, an apparently increased length from the nasal root to the nasal base. Evidence: PCS. Frequency: 1/5. (PMID:35304602)
- Febrile seizure (within the age range of 3 months to 6 years) (HP:0002373): A febrile seizure is any type of seizure (most often a generalized tonic-clonic seizure) occurring with fever (at least 38 degrees Celsius) but in the absence of central nervous system infection, severe metabolic disturbance or other alternative precipitant in children between the ages of 3 months and 6 years. Evidence: PCS. Frequency: 1/1. (PMID:35304602)
- Bifid uvula (HP:0000193): Uvula separated into two parts most easily seen at the tip. Evidence: PCS. Frequency: 1/5. (PMID:35304602)
- Short neck (HP:0000470): Diminished length of the neck. Evidence: PCS. Frequency: 3/5. (PMID:35304602)
- Posterior embryotoxon (HP:0000627): A posterior embryotoxon is the presence of a prominent and anteriorly displaced line of Schwalbe. Evidence: PCS. Frequency: 1/1. (PMID:29620724)
- Ptosis (HP:0000508): The upper eyelid margin is positioned 3 mm or more lower than usual and covers the superior portion of the iris (objective); or, the upper lid margin obscures at least part of the pupil (subjective). Evidence: PCS. Frequency: 4/4. (PMID:35304602)
- Micrognathia (HP:0000347): Developmental hypoplasia of the mandible. Evidence: PCS. Frequency: 2/2. (PMID:40491293;PMID:29620724)
- Epicanthus (HP:0000286): A fold of skin starting above the medial aspect of the upper eyelid and arching downward to cover, pass in front of and lateral to the medial canthus. Evidence: PCS. Frequency: 1/1. (PMID:29620724)
- Mild intellectual disability (HP:0001256): Mild intellectual disability (ID) is defined as a type of ID characterized by mildly sub-average adaptive functioning and intellectual functioning, with an intelligence quotient (IQ) the range of 50-69. Evidence: PCS. Frequency: 1/1. (PMID:40491293)
- Moderate intellectual disability (HP:0002342): Moderate intellectual disability (ID) is defined as a type of ID characterized by moderately sub-average adaptive functioning and intellectual functioning, with an intelligence quotient (IQ) the range of 35-49. Evidence: PCS. Frequency: 4/5. (PMID:35304602)
- Seizure (HP:0001250): A seizure is an intermittent abnormality of nervous system physiology characterized by a transient occurrence of signs and/or symptoms due to abnormal excessive or synchronous neuronal activity in the brain. Evidence: PCS. Frequency: 2/3. (PMID:35304602;PMID:40491293)
- Hypotonia (HP:0001252): Hypotonia is an abnormally low muscle tone (the amount of tension or resistance to movement in a muscle). Even when relaxed, muscles have a continuous and passive partial contraction which provides some resistance to passive stretching. Hypotonia thus manifests as diminished resistance to passive stretching. Hypotonia is not the same as muscle weakness, although the two conditions can co-exist. Evidence: PCS. Frequency: 3/3. (PMID:35304602)
- Myoclonic seizure (HP:0032794): A myoclonic seizure is a type of motor seizure characterized by sudden, brief (<100 ms) involuntary single or multiple contraction of muscles or muscle groups of variable topography (axial, proximal limb, distal). Myoclonus is less regularly repetitive and less sustained than is clonus. Evidence: PCS. Frequency: 1/1. (PMID:35304602)
- Sparse eyebrow (HP:0045075): Decreased density/number of eyebrow hairs. Evidence: PCS. Frequency: 1/1. (PMID:40491293)
- Smooth philtrum (HP:0000319): Flat skin surface, with no ridge formation in the central region of the upper lip between the nasal base and upper vermilion border. Evidence: PCS. Frequency: 1/1. (PMID:40491293)
- Hypertelorism (HP:0000316): Interpupillary distance more than 2 SD above the mean (alternatively, the appearance of an increased interpupillary distance or widely spaced eyes). Evidence: PCS. Frequency: 3/5. (PMID:35304602)
- Aortic root aneurysm (HP:0002616): An abnormal localized widening (dilatation) of the aortic root. Evidence: PCS. Frequency: 1/5. (PMID:35304602)
- Rieger anomaly (HP:0000558): A congenital malformation of the anterior segment characterized by iridicorneal malformation, glaucoma, iris stroma hypoplasia, posterior embryotoxon, and corneal opacities. Evidence: PCS. Frequency: 1/5. (PMID:35304602)
- Esodeviation (HP:0020045): A manifest or latent ocular deviation in which one or both eyes tends to deviate nasally. Evidence: PCS. Frequency: 1/3. (PMID:35304602)
- Patent ductus arteriosus (HP:0001643): In utero, the ductus arteriosus (DA) serves to divert ventricular output away from the lungs and toward the placenta by connecting the main pulmonary artery to the descending aorta. A patent ductus arteriosus (PDA) in the first 3 days of life is a physiologic shunt in healthy term and preterm newborn infants, and normally is substantially closed within about 24 hours after bith and completely closed after about three weeks. Failure of physiologcal closure is referred to a persistent or patent ductus arteriosus (PDA). Depending on the degree of left-to-right shunting, PDA can have clinical consequences. Evidence: PCS. Frequency: 1/1. (PMID:29620724)
- Flat occiput (HP:0005469): Reduced convexity of the occiput (posterior part of skull). Evidence: PCS. Frequency: 1/5. (PMID:35304602)
- Cleft palate (HP:0000175): Cleft palate is a developmental defect of the palate resulting from a failure of fusion of the palatine processes and manifesting as a separation of the roof of the mouth (soft and hard palate). Evidence: PCS. Frequency: 1/5. (PMID:35304602)
- Thick eyebrow (HP:0000574): Increased density/number and/or increased diameter of eyebrow hairs. Evidence: PCS. Frequency: 1/1. (PMID:35304602)
- EEG abnormality (HP:0002353): Abnormality observed by electroencephalogram (EEG), which is used to record of the brain's spontaneous electrical activity from multiple electrodes placed on the scalp. Evidence: PCS. Frequency: 2/2. (PMID:35304602)
- Delayed skeletal maturation (HP:0002750): A decreased rate of skeletal maturation. Delayed skeletal maturation can be diagnosed on the basis of an estimation of the bone age from radiographs of specific bones in the human body. Evidence: PCS. Frequency: 1/1. (PMID:35304602)
- Full cheeks (HP:0000293): Increased prominence or roundness of soft tissues between zygomata and mandible. Evidence: PCS. Frequency: 1/1. (PMID:29620724)
- Feeding difficulties (HP:0011968): Impaired ability to eat related to problems gathering food and getting ready to suck, chew, or swallow it. Evidence: PCS. Frequency: 1/1. (PMID:35304602)
- Global developmental delay (HP:0001263): A delay in the achievement of motor or mental milestones in the domains of development of a child, including motor skills, speech and language, cognitive skills, and social and emotional skills. This term should only be used to describe children younger than five years of age. Evidence: PCS. Frequency: 2/2. (PMID:35304602;PMID:29620724)
- Low anterior hairline (HP:0000294): Distance between the hairline (trichion) and the glabella (the most prominent point on the frontal bone above the root of the nose), in the midline, more than two SD below the mean. Alternatively, an apparently decreased distance between the hairline and the glabella. Evidence: PCS. Frequency: 4/6. (PMID:35304602;PMID:29620724)
- Umbilical hernia (HP:0001537): Protrusion of abdominal contents through a defect in the abdominal wall musculature around the umbilicus. Skin and subcutaneous tissue overlie the defect. Evidence: PCS. Frequency: 1/1. (PMID:29620724)
- Hypotelorism (HP:0000601): Interpupillary distance less than 2 SD below the mean (alternatively, the appearance of an decreased interpupillary distance or closely spaced eyes). Evidence: PCS. Frequency: 1/1. (PMID:29620724)
- Petechiae (HP:0000967): Petechiae are pinpoint-sized reddish/purple spots, resembling a rash, that appear just under the skin or a mucous membrane when capillaries have ruptured and some superficial bleeding into the skin has happened. This term refers to an abnormally increased susceptibility to developing petechiae. Evidence: PCS. Frequency: 1/1. (PMID:35304602)
- Short thumb (HP:0009778): Hypoplasia (congenital reduction in size) of the thumb. Evidence: PCS. Frequency: 0/5. (PMID:35304602)
- Apnea (HP:0002104): Lack of breathing with no movement of the respiratory muscles and no exchange of air in the lungs. This term refers to a disposition to have recurrent episodes of apnea rather than to a single event. Evidence: PCS. Frequency: 1/1. (PMID:29620724)
- Patent foramen ovale (HP:0001655): Failure of the foramen ovale to seal postnatally, leaving a potential conduit between the left and right cardiac atria. Evidence: PCS. Frequency: 1/1. (PMID:29620724)
- Wide nose (HP:0000445): Interalar distance more than two standard deviations above the mean for age, i.e., an apparently increased width of the nasal base and alae. Evidence: PCS. Frequency: 0/5. (PMID:35304602)
- Borderline intellectual disability (HP:0006889): Borderline intellectual disability is defined as an intelligence quotient (IQ) in the range of 70-85. Evidence: PCS. Frequency: 1/5. (PMID:35304602)
- Inguinal hernia (HP:0000023): Protrusion of the contents of the abdominal cavity through the inguinal canal. Evidence: PCS. Frequency: 2/2. (PMID:35304602;PMID:29620724)
- Hypermetropia (HP:0000540): An abnormality of refraction characterized by the ability to see objects in the distance clearly, while objects nearby appear blurry. Evidence: PCS. Frequency: 0/4. (PMID:35304602)
- Slurred speech (HP:0001350): Abnormal coordination of muscles involved in speech. Evidence: PCS. Frequency: 1/1. (PMID:35304602)
- Frequent temper tantrums (HP:0025161): Temper tantrums that occur more frequently compared to the temper tantrums that are a part of the normal developmental process. Evidence: PCS. Frequency: 1/1. (PMID:35304602)
- Ventricular septal defect (HP:0001629): A hole between the two bottom chambers (ventricles) of the heart. The defect is centered around the most superior aspect of the ventricular septum. Evidence: PCS. Frequency: 1/1. (PMID:29620724)
- Narrow chest (HP:0000774): Reduced width of the chest from side to side, associated with a reduced distance from the sternal notch to the tip of the shoulder. Evidence: PCS. Frequency: 1/1. (PMID:40491293)
- Wide mouth (HP:0000154): Distance between the oral commissures more than 2 SD above the mean. Alternatively, an apparently increased width of the oral aperture (subjective). Evidence: PCS. Frequency: 1/1. (PMID:29620724)
- Narrow philtrum (HP:0011829): Distance between the philtral ridges, measured just above the vermilion border, more than 2 standard deviations below the mean. Alternatively, an apparently decreased distance between the ridges of the philtrum. Evidence: PCS. Frequency: 0/5. (PMID:35304602)
- Iris atrophy (HP:0001089): Loss of iris tissue (atrophy). Evidence: PCS. Frequency: 1/5. (PMID:35304602)
- Myopathic facies (HP:0002058): A facial appearance characteristic of myopathic conditions. The face appears expressionless with sunken cheeks, bilateral ptosis, and inability to elevate the corners of the mouth, due to muscle weakness. Evidence: PCS. Frequency: 1/1. (PMID:35304602)
- Craniosynostosis (HP:0001363): Craniosynostosis refers to the premature closure of the cranial sutures. Primary craniosynostosis refers to the closure of one or more sutures due to abnormalities in skull development, and secondary craniosynostosis results from failure of brain growth. Evidence: PCS. Frequency: 1/1. (PMID:29620724)
- Small face (HP:0000274): A face that is short and narrow. Evidence: PCS. Frequency: 1/5. (PMID:35304602)
- Brain abscess (HP:0030049): A collection of pus, immune cells, and other material in the brain. Evidence: PCS. Frequency: 1/1. (PMID:35304602)
- Wide nasal bridge (HP:0000431): Increased breadth of the nasal bridge (and with it, the nasal root). Evidence: PCS. Frequency: 2/5. (PMID:35304602)
- Cholelithiasis (HP:0001081): Hard, pebble-like deposits that form within the gallbladder. Evidence: PCS. Frequency: 1/1. (PMID:35304602)
- Cholecystitis (HP:0001082): The presence of inflammatory changes in the gallbladder. Evidence: PCS. Frequency: 1/1. (PMID:35304602)
- Depressed nasal bridge (HP:0005280): Posterior positioning of the nasal root in relation to the overall facial profile for age. Evidence: PCS. Frequency: 1/1. (PMID:29620724)
- Broad thumb (HP:0011304): Increased thumb width without increased dorso-ventral dimension. Evidence: PCS. Frequency: 2/2. (PMID:35304602)
- Tetralogy of Fallot (HP:0001636): A congenital cardiac malformation comprising pulmonary stenosis, overriding aorta, ventricular septum defect, and right ventricular hypertrophy. The diagnosis of TOF is made if at least three of the four above mentioned features are present. Evidence: PCS. Frequency: 3/6. (PMID:35304602;PMID:40491293)
- Hemolytic anemia (HP:0001878): A type of anemia caused by premature destruction of red blood cells (hemolysis). Evidence: PCS. Frequency: 1/1. (PMID:35304602)
- Intrauterine growth retardation (HP:0001511): An abnormal restriction of fetal growth with fetal weight below the tenth percentile for gestational age. Evidence: PCS. Frequency: 1/1. (PMID:29620724)
- Plagiocephaly (HP:0001357): Asymmetric head shape, which is usually a combination of unilateral occipital flattening with ipsilateral frontal prominence, leading to rhomboid cranial shape. Evidence: PCS. Frequency: 1/1. (PMID:29620724)
- Synophrys (HP:0000664): Meeting of the medial eyebrows in the midline. Evidence: PCS. Frequency: 2/5. (PMID:35304602)
- Atrial septal defect (HP:0001631): Atrial septal defect (ASD) is a congenital abnormality of the interatrial septum that enables blood flow between the left and right atria via the interatrial septum. Evidence: PCS. Frequency: 1/5. (PMID:35304602)
- Myopia (HP:0000545): An abnormality of refraction characterized by the ability to see objects nearby clearly, while objects in the distance appear blurry. Evidence: PCS. Frequency: 1/1. (PMID:40491293)
- Kidney stone (HP:0000787): Kidney stones (calculi) are mineral concretions in the renal calyces and pelvis that are found free or attached to the renal papillae. Evidence: PCS. Frequency: 3/3. (PMID:35304602)